- Aphasia (HP:0002381): An acquired language impairment of some or all of the abilities to produce or comprehend speech and to read or write. Evidence: TAS. Frequency: Very frequent (HP:0040281). (ORPHA:100069)
- Brain atrophy (HP:0012444): Partial or complete wasting (loss) of brain tissue that was once present. Evidence: TAS. Frequency: Very frequent (HP:0040281). (ORPHA:100069)
- Visual agnosia (HP:0030222): The condition is known as visual agnosia, which refers to the inability to recognize objects that are visually presented, even though the individual may have normal visual field, acuity, color vision, brightness discrimination, language, and memory. Evidence: TAS. Frequency: Very frequent (HP:0040281). (ORPHA:100069)
- Anomic aphasia (HP:0030784): An inability to name people and objects that are correctly perceived. The individual is able to describe the object in question, but cannot provide the name. Evidence: TAS. Frequency: Very frequent (HP:0040281). (ORPHA:100069)
- Dementia (HP:0000726): A loss of global cognitive ability of sufficient amount to interfere with normal social or occupational function. Dementia represents a loss of previously present cognitive abilities, generally in adults, and can affect memory, thinking, language, judgment, and behavior. Evidence: TAS. Frequency: Frequent (HP:0040282). (ORPHA:100069)
- Abnormal speech pattern (HP:0002167): An abnormality in the sound (volume) or cadence (rate) of speech. Evidence: TAS. Frequency: Frequent (HP:0040282). (ORPHA:100069)
- Dyslexia (HP:0010522): A learning disorder characterized primarily by difficulties in learning to read and spell. Dyslectic children also exhibit a tendency to read words from right to left and to confuse letters such as b and d whose orientation is important for their identification. Children with dyslexia appear to be impaired in phonemic skills (the ability to associate visual symbols with the sounds they represent). Evidence: TAS. Frequency: Frequent (HP:0040282). (ORPHA:100069)
- Alexia (HP:0010523): An acquired type of sensory aphasia where damage to the brain leads to the loss of the ability to read. Evidence: TAS. Frequency: Frequent (HP:0040282). (ORPHA:100069)
- Dysgraphia (HP:0010526): A writing disability in the absence of motor or sensory deficits of the upper extremities, resulting in an impairment in the ability to write regardless of the ability to read and not due to intellectual impairment. Evidence: TAS. Frequency: Frequent (HP:0040282). (ORPHA:100069)
- Abulia (HP:0012671): Abulia is characterized by difficulty in initiating and sustaining spontaneous movements; the person often appears frozen but will move hesitantly on request. There are frequently substantial reductions in emotional responsiveness, spontaneous speech, and social interaction. The individual appears to be content to remain still and inactive with minimal movement, but moves or reacts hesitantly in response to interactions. Evidence: TAS. Frequency: Frequent (HP:0040282). (ORPHA:100069)
These phenotypes are associated with the disease Semantic dementia (ORPHA:100069).